Phenotypes associated with the disease porokeratosis 8, disseminated superficial actinic type (OMIM:616063):
- Juvenile onset (HP:0003621): Onset of signs or symptoms of disease between the age of 5 and 15 years. Evidence: PCS. (PMID:25180256)
- Young adult onset (HP:0011462): Onset of disease at the age of between 16 and 40 years. Evidence: PCS. (PMID:25180256)
- Papule (HP:0200034): A circumscribed, solid elevation of skin with no visible fluid, varying in size from a pinhead to less than 10mm in diameter at the widest point. Evidence: PCS. (PMID:25180256)
- Porokeratosis (HP:0200044): A clonal disorder of keratinization with one or multiple atrophic patches surrounded by a clinically and histologically distinctive hyperkeratotic ridgelike border called the cornoid lamella. Evidence: PCS. (PMID:25180256)
- Autosomal dominant inheritance (HP:0000006): A mode of inheritance that is observed for traits related to a gene encoded on one of the autosomes (i.e., the human chromosomes 1-22) in which a trait manifests in heterozygotes. In the context of medical genetics, an autosomal dominant disorder is caused when a single copy of the mutant allele is present. Males and females are affected equally, and can both transmit the disorder with a risk of 50% for each child of inheriting the mutant allele. Evidence: PCS. (PMID:25180256)